- Hyperemesis gravidarum (HP:0012188): Excessive vomiting in early pregnancy, leading to the loss of 5% or more of body weight. Evidence: PCS. (PMID:38092039)
- Autosomal dominant inheritance (HP:0000006): A mode of inheritance that is observed for traits related to a gene encoded on one of the autosomes (i.e., the human chromosomes 1-22) in which a trait manifests in heterozygotes. In the context of medical genetics, an autosomal dominant disorder is caused when a single copy of the mutant allele is present. Males and females are affected equally, and can both transmit the disorder with a risk of 50% for each child of inheriting the mutant allele. Evidence: PCS. (PMID:38092039)
These phenotypes are associated with the disease hyperemesis gravidarum, susceptibility to (OMIM:620730).